Phenotypes associated with the disease pheochromocytoma/paraganglioma syndrome 5 (OMIM:614165):
- Paraganglioma (HP:0002668): A carotid body tumor (also called paraganglionoma or chemodectoma) is a tumor found in the upper neck at the branching of the carotid artery. They arise from the chemoreceptor organ (paraganglion) located in the adventitia of the carotid artery bifurcation. Evidence: PCS. Frequency: 2/2. (PMID:23750034;PMID:20484225)
- Autosomal dominant inheritance (HP:0000006): A mode of inheritance that is observed for traits related to a gene encoded on one of the autosomes (i.e., the human chromosomes 1-22) in which a trait manifests in heterozygotes. In the context of medical genetics, an autosomal dominant disorder is caused when a single copy of the mutant allele is present. Males and females are affected equally, and can both transmit the disorder with a risk of 50% for each child of inheriting the mutant allele. Evidence: PCS. (PMID:20484225)